- Cleft palate (HP:0000175): Cleft palate is a developmental defect of the palate resulting from a failure of fusion of the palatine processes and manifesting as a separation of the roof of the mouth (soft and hard palate). Evidence: IEA. (OMIM:147800)
- Talipes equinovarus (HP:0001762): Talipes equinovarus (also called clubfoot) typically has four main components: inversion and adduction of the forefoot; inversion of the heel and hindfoot; equinus (limitation of extension) of the ankle and subtalar joint; and internal rotation of the leg. Evidence: IEA. (OMIM:147800)
- Open mouth (HP:0000194): A facial appearance characterized by a permanently or nearly permanently opened mouth. Evidence: IEA. (OMIM:147800)
- Flexion contracture (HP:0001371): A flexion contracture is a bent (flexed) joint that cannot be straightened actively or passively. It is thus a chronic loss of joint motion due to structural changes in muscle, tendons, ligaments, or skin that prevents normal movement of joints. Evidence: IEA. (OMIM:147800)
- Ventricular septal defect (HP:0001629): A hole between the two bottom chambers (ventricles) of the heart. The defect is centered around the most superior aspect of the ventricular septum. Evidence: IEA. (OMIM:147800)
- Ptosis (HP:0000508): The upper eyelid margin is positioned 3 mm or more lower than usual and covers the superior portion of the iris (objective); or, the upper lid margin obscures at least part of the pupil (subjective). Evidence: IEA. (OMIM:147800)
- Hydrocephalus (HP:0000238): Hydrocephalus is an active distension of the ventricular system of the brain resulting from inadequate passage of CSF from its point of production within the cerebral ventricles to its point of absorption into the systemic circulation. Evidence: IEA. (OMIM:147800)
- Dandy-Walker malformation (HP:0001305): A congenital brain malformation typically characterized by incomplete formation of the cerebellar vermis, dilation of the fourth ventricle, and enlargement of the posterior fossa. In layman's terms, Dandy Walker malformation is a cyst in the cerebellum (typically symmetrical) that is involved with the fourth ventricle. This may interfere with the ability to drain cerebrospinal fluid from the brain, resulting in hydrocephalus. Dandy Walker cysts are formed during early embryonic development, while the brain forms. The cyst in the cerebellum typically has several blood vessels running through it connecting to the brain, thereby prohibiting surgical removal. Evidence: IEA. (OMIM:147800)
- Death in infancy (HP:0001522): Death within the first 24 months of life. Evidence: IEA. (OMIM:147800)
- Congenital neuroblastoma (HP:0006742). Evidence: IEA. (OMIM:147800)
- Abnormal pinna morphology (HP:0000377): An abnormality of the pinna, which is also referred to as the auricle or external ear. Evidence: IEA. (OMIM:147800)
- Autosomal dominant inheritance (HP:0000006): A mode of inheritance that is observed for traits related to a gene encoded on one of the autosomes (i.e., the human chromosomes 1-22) in which a trait manifests in heterozygotes. In the context of medical genetics, an autosomal dominant disorder is caused when a single copy of the mutant allele is present. Males and females are affected equally, and can both transmit the disorder with a risk of 50% for each child of inheriting the mutant allele. Evidence: IEA. (OMIM:147800)
- Slender finger (HP:0001238): Fingers that are disproportionately narrow (reduced girth) for the hand/foot size or build of the individual. Evidence: IEA. (OMIM:147800)
These phenotypes are associated with the disease Aase-Smith syndrome (OMIM:147800).